Phenotypes associated with the disease deafness, unilateral (OMIM:125000):
- Unilateral deafness (HP:0009900): A unilateral absence of sensory perception of sound. Evidence: TAS. (OMIM:125000)
- Autosomal dominant inheritance (HP:0000006): A mode of inheritance that is observed for traits related to a gene encoded on one of the autosomes (i.e., the human chromosomes 1-22) in which a trait manifests in heterozygotes. In the context of medical genetics, an autosomal dominant disorder is caused when a single copy of the mutant allele is present. Males and females are affected equally, and can both transmit the disorder with a risk of 50% for each child of inheriting the mutant allele. Evidence: TAS. (OMIM:125000)